- Limited pronation/supination of forearm (HP:0006394): A limitation of the ability to place the forearm in a position such that the palm faces anteriorly (supination) and to place the forearm in a position such that the palm faces posteriorly (pronation). Evidence: TAS. (OMIM:179300)
- Autosomal dominant inheritance (HP:0000006): A mode of inheritance that is observed for traits related to a gene encoded on one of the autosomes (i.e., the human chromosomes 1-22) in which a trait manifests in heterozygotes. In the context of medical genetics, an autosomal dominant disorder is caused when a single copy of the mutant allele is present. Males and females are affected equally, and can both transmit the disorder with a risk of 50% for each child of inheriting the mutant allele. Evidence: PCS. (PMID:31138930)
- Radioulnar synostosis (HP:0002974): An abnormal osseous union (fusion) between the radius and the ulna. Evidence: PCS. Frequency: 22/22. (PMID:31138930)
These phenotypes are associated with the disease radioulnar synostosis, nonsyndromic, susceptibility to (OMIM:179300).